- Hearing impairment (HP:0000365): A decreased magnitude of the sensory perception of sound. Evidence: TAS. Frequency: Very frequent (HP:0040281). (ORPHA:42665)
- Abnormal anterior chamber morphology (HP:0000593): Abnormality of the anterior chamber, which is the space in the eye that is behind the cornea and in front of the iris. Evidence: TAS. Frequency: Very frequent (HP:0040281). (ORPHA:42665)
- Abnormal skin pigmentation (HP:0001000): An abnormality of the pigmentation of the skin. Evidence: TAS. Frequency: Very frequent (HP:0040281). (ORPHA:42665)
- Hypopigmentation of the skin (HP:0001010): A reduction of skin color related to a decrease in melanin production and deposition. Evidence: TAS. Frequency: Very frequent (HP:0040281). (ORPHA:42665)
- White eyebrow (HP:0002226): White color (lack of pigmentation) of the eyebrow. Evidence: TAS. Frequency: Very frequent (HP:0040281). (ORPHA:42665)
- Hypopigmentation of hair (HP:0005599). Evidence: TAS. Frequency: Very frequent (HP:0040281). (ORPHA:42665)
These phenotypes are associated with the disease Tietz syndrome (ORPHA:42665).